Phenotypes associated with the disease Warburg micro syndrome 2 (OMIM:614225):
- Congenital onset (HP:0003577): A phenotypic abnormality that is present at birth. Evidence: PCS. Frequency: 1/1. (PMID:20967465)
- Clinodactyly of the 4th toe (HP:0011918): Bending or curvature of a fourth toe in the tibial direction (i.e., towards the big toe). Evidence: PCS. Frequency: 1/1. (PMID:20967465)
- Small scrotum (HP:0000046): Apparently small scrotum for age. Evidence: TAS. (OMIM:614225)
- Flexion contracture (HP:0001371): A flexion contracture is a bent (flexed) joint that cannot be straightened actively or passively. It is thus a chronic loss of joint motion due to structural changes in muscle, tendons, ligaments, or skin that prevents normal movement of joints. Evidence: TAS. (OMIM:614225)
- Global brain atrophy (HP:0002283): Unlocalized atrophy of the brain with decreased total brain matter volume and increased ventricular size. Evidence: PCS. Frequency: 1/1. (PMID:20967465)
- Microcornea (HP:0000482): A congenital abnormality of the cornea in which the cornea and the anterior segment of the eye are smaller than normal. The horizontal diameter of the cornea does not reach 10 mm even in adulthood. Evidence: TAS. (OMIM:614225)
- Short nose (HP:0003196): Distance from nasion to subnasale more than two standard deviations below the mean, or alternatively, an apparently decreased length from the nasal root to the nasal tip. Evidence: PCS. Frequency: 1/1. (PMID:20967465)
- Hypotonia (HP:0001252): Hypotonia is an abnormally low muscle tone (the amount of tension or resistance to movement in a muscle). Even when relaxed, muscles have a continuous and passive partial contraction which provides some resistance to passive stretching. Hypotonia thus manifests as diminished resistance to passive stretching. Hypotonia is not the same as muscle weakness, although the two conditions can co-exist. Evidence: PCS. Frequency: 1/1. (PMID:20967465)
- Asymmetry of the ears (HP:0010722): An asymmetriy, i.e., difference in size, shape or position between the left and right ear. Evidence: PCS. Frequency: 1/1. (PMID:20967465)
- Severe intellectual disability (HP:0010864): Severe intellectual disability (ID) is defined as a type of ID characterized by severely sub-average adaptive functioning and intellectual functioning, with an intelligence quotient (IQ) the range of 20-34. Evidence: TAS. (OMIM:614225)
- Cataract (HP:0000518): A cataract is an opacity or clouding that develops in the crystalline lens of the eye or in its capsule. Evidence: PCS. Frequency: 1/1. Onset: Congenital onset (HP:0003577). (PMID:20967465)
- Developmental cataract (HP:0000519): A cataract that occurs congenitally as the result of a developmental defect, in contrast to the majority of cataracts that occur in adulthood as the result of degenerative changes of the lens. Evidence: TAS. (OMIM:614225)
- Overlapping toe (HP:0001845): Describes a foot digit resting on the dorsal surface of an adjacent digit when the foot is at rest. Initially clawing may be dynamic and only noticeable on walking. Over time the plantar plate tears, subluxation occurs at the metatarsophalangeal joint (MTPJ), and the deformity becomes permanent. Evidence: TAS. (OMIM:614225)
- Postnatal growth retardation (HP:0008897): Slow or limited growth after birth. Evidence: TAS. (OMIM:614225)
- Hypoplastic labia majora (HP:0000059): Undergrowth of the outer labia. Evidence: TAS. (OMIM:614225)
- Undetectable visual evoked potentials (HP:0007965). Evidence: TAS. (OMIM:614225)
- Clinodactyly of the 5th toe (HP:0001864): Bending or curvature of a fifth toe in the tibial direction (i.e., towards the big toe). Evidence: PCS. Frequency: 1/1. (PMID:20967465)
- Axial hypotonia (HP:0008936): Muscular hypotonia (abnormally low muscle tone) affecting the musculature of the trunk. Evidence: TAS. (OMIM:614225)
- Microcephaly (HP:0000252): Head circumference below 2 standard deviations below the mean for age and gender. Evidence: PCS. Frequency: 1/1. (PMID:20967465)
- Micropenis (HP:0000054): Abnormally small penis. At birth, the normal penis is about 3 cm (stretched length from pubic tubercle to tip of penis) with micropenis less than 2.0-2.5 cm. Evidence: TAS. (OMIM:614225)
- Spastic diplegia (HP:0001264): Spasticity (neuromuscular hypertonia) primarily in the muscles of the legs, hips, and pelvis. Evidence: IEA. (OMIM:614225)
- Absent speech (HP:0001344): Complete lack of development of speech and language abilities. Evidence: PCS. Frequency: 1/1. (PMID:20967465)
- Hypoplasia of the corpus callosum (HP:0002079): Underdevelopment of the corpus callosum. Evidence: PCS. Frequency: 1/1. (PMID:20967465)
- Deeply set eye (HP:0000490): An eye that is more deeply recessed into the plane of the face than is typical. Evidence: PCS. Frequency: 1/1. (PMID:20967465)
- Global developmental delay (HP:0001263): A delay in the achievement of motor or mental milestones in the domains of development of a child, including motor skills, speech and language, cognitive skills, and social and emotional skills. This term should only be used to describe children younger than five years of age. Evidence: PCS. Frequency: 1/1. (PMID:20967465)
- Low anterior hairline (HP:0000294): Distance between the hairline (trichion) and the glabella (the most prominent point on the frontal bone above the root of the nose), in the midline, more than two SD below the mean. Alternatively, an apparently decreased distance between the hairline and the glabella. Evidence: TAS. (OMIM:614225)
- Secondary microcephaly (HP:0005484): Head circumference which falls below 2 standard deviations below the mean for age and gender because of insufficient head growth after birth. Evidence: TAS. (OMIM:614225)
- Severe global developmental delay (HP:0011344): A severe delay in the achievement of motor or mental milestones in the domains of development of a child. Evidence: TAS. (OMIM:614225)
- Prominent nasal bridge (HP:0000426): Anterior positioning of the nasal root in comparison to the usual positioning for age. Evidence: PCS. Frequency: 1/1. (PMID:20967465)
- Autosomal recessive inheritance (HP:0000007): A mode of inheritance that is observed for traits related to a gene encoded on one of the autosomes (i.e., the human chromosomes 1-22) in which a trait manifests in individuals with two pathogenic alleles, either homozygotes (two copies of the same mutant allele) or compound heterozygotes (whereby each copy of a gene has a distinct mutant allele). Evidence: PCS. (PMID:20967465)
- Microphthalmia (HP:0000568): A developmental anomaly characterized by abnormal smallness of one or both eyes. Evidence: PCS. Frequency: 1/1. (PMID:20967465)
- Optic atrophy (HP:0000648): Atrophy of the optic nerve. Optic atrophy results from the death of the retinal ganglion cell axons that comprise the optic nerve and manifesting as a pale optic nerve on fundoscopy. Evidence: TAS. (OMIM:614225)
- Macrotia (HP:0000400): Median longitudinal ear length greater than two standard deviations above the mean and median ear width greater than two standard deviations above the mean (objective); or, apparent increase in length and width of the pinna (subjective). Evidence: PCS. Frequency: 1/1. (PMID:20967465)
- Brachycephaly (HP:0000248): An abnormality of skull shape characterized by a decreased anterior-posterior diameter. That is, a cephalic index greater than 81%. Alternatively, an apparently shortened anteroposterior dimension (length) of the head compared to width. Evidence: PCS. Frequency: 1/1. (PMID:20967465)
- Cryptorchidism (HP:0000028): Testis in inguinal canal. That is, absence of one or both testes from the scrotum owing to failure of the testis or testes to descend through the inguinal canal to the scrotum. Evidence: TAS. (OMIM:614225)
- Polymicrogyria (HP:0002126): Polymicrogyria is a congenital malformation of the cerebral cortex characterized by abnormal cortical layering (lamination) and an excessive number of small gyri (folds). Evidence: PCS. Frequency: 1/1. (PMID:20967465)